Phenotypes associated with the disease Axenfeld-Rieger syndrome type 2 (OMIM:601499):
- Anal stenosis (HP:0002025): Abnormal narrowing of the anal opening. Evidence: IEA. (OMIM:601499)
- Opacification of the corneal stroma (HP:0007759): Reduced transparency of the stroma of cornea. Evidence: IEA. (OMIM:601499)
- Hearing impairment (HP:0000365): A decreased magnitude of the sensory perception of sound. Evidence: IEA. (OMIM:601499)
- Wide nasal bridge (HP:0000431): Increased breadth of the nasal bridge (and with it, the nasal root). Evidence: IEA. (OMIM:601499)
- Inguinal hernia (HP:0000023): Protrusion of the contents of the abdominal cavity through the inguinal canal. Evidence: IEA. (OMIM:601499)
- Everted lower lip vermilion (HP:0000232): An abnormal configuration of the lower lip such that it is turned outward i.e., everted, with the Inner aspect of the lower lip vermilion (normally opposing the teeth) being visible in a frontal view. Evidence: IEA. (OMIM:601499)
- Microcornea (HP:0000482): A congenital abnormality of the cornea in which the cornea and the anterior segment of the eye are smaller than normal. The horizontal diameter of the cornea does not reach 10 mm even in adulthood. Evidence: IEA. (OMIM:601499)
- Microdontia (HP:0000691): Decreased size of the teeth, which can be defined as a mesiodistal tooth diameter (width) more than 2 SD below mean. Alternatively, an apparently decreased maximum width of tooth. Evidence: IEA. (OMIM:601499)
- Telecanthus (HP:0000506): Distance between the inner canthi more than two standard deviations above the mean (objective); or, apparently increased distance between the inner canthi. Evidence: IEA. (OMIM:601499)
- Blindness (HP:0000618): Blindness is the condition of lacking visual perception defined as a profound reduction in visual perception. On the 6m visual acuity scale, blindness is defined as less than 3/60. On the 20ft visual acuity scale, blindness is defined as less than 20/400. On the decimal visual acuity scale, blindness is defined as less than 0.05. Blindness is typically characterized by a visual field of no greater than 10 degrees in radius around central fixation. Evidence: IEA. (OMIM:601499)
- Hypertelorism (HP:0000316): Interpupillary distance more than 2 SD above the mean (alternatively, the appearance of an increased interpupillary distance or widely spaced eyes). Evidence: IEA. (OMIM:601499)
- Hypoplasia of the maxilla (HP:0000327): Abnormally small dimension of the Maxilla. Usually creating a malocclusion or malalignment between the upper and lower teeth or resulting in a deficient amount of projection of the base of the nose and lower midface region. Evidence: IEA. (OMIM:601499)
- Hypodontia (HP:0000668): The absence of five or less teeth from the normal series by a failure to develop. Evidence: IEA. (OMIM:601499)
- Umbilical hernia (HP:0001537): Protrusion of abdominal contents through a defect in the abdominal wall musculature around the umbilicus. Skin and subcutaneous tissue overlie the defect. Evidence: IEA. (OMIM:601499)
- Hydrocephalus (HP:0000238): Hydrocephalus is an active distension of the ventricular system of the brain resulting from inadequate passage of CSF from its point of production within the cerebral ventricles to its point of absorption into the systemic circulation. Evidence: IEA. (OMIM:601499)
- Abnormal cardiovascular system morphology (HP:0030680): Any structural anomaly of the heart and blood vessels. Evidence: IEA. (OMIM:601499)
- Abnormal heart morphology (HP:0001627): Any structural anomaly of the heart. Evidence: TAS. (OMIM:601499)
- Hypospadias (HP:0000047): Abnormal position of urethral meatus on the ventral penile shaft (underside) characterized by displacement of the urethral meatus from the tip of the glans penis to the ventral surface of the penis, scrotum, or perineum. Evidence: IEA. (OMIM:601499)
- Short philtrum (HP:0000322): Distance between nasal base and midline upper lip vermilion border more than 2 SD below the mean. Alternatively, an apparently decreased distance between nasal base and midline upper lip vermilion border. Evidence: IEA. (OMIM:601499)
- Autosomal dominant inheritance (HP:0000006): A mode of inheritance that is observed for traits related to a gene encoded on one of the autosomes (i.e., the human chromosomes 1-22) in which a trait manifests in heterozygotes. In the context of medical genetics, an autosomal dominant disorder is caused when a single copy of the mutant allele is present. Males and females are affected equally, and can both transmit the disorder with a risk of 50% for each child of inheriting the mutant allele. Evidence: IEA. (OMIM:601499)
- Cryptorchidism (HP:0000028): Testis in inguinal canal. That is, absence of one or both testes from the scrotum owing to failure of the testis or testes to descend through the inguinal canal to the scrotum. Evidence: IEA. (OMIM:601499)
- Mandibular prognathia (HP:0000303): Abnormal prominence of the chin related to increased length of the mandible. Evidence: IEA. (OMIM:601499)
- Glaucoma (HP:0000501): Glaucoma refers loss of retinal ganglion cells in a characteristic pattern of optic neuropathy usually associated with increased intraocular pressure. Evidence: IEA. (OMIM:601499)
- Anterior chamber synechiae (HP:0007833). Evidence: IEA. (OMIM:601499)